- Microcephaly (HP:0000252): Head circumference below 2 standard deviations below the mean for age and gender. Evidence: PCS. Frequency: 2/19. (PMID:30351409)
- Delayed speech and language development (HP:0000750): A degree of language development that is significantly below the norm for a child of a specified age. Evidence: PCS. Frequency: 2/19. (PMID:30351409)
- Seizure (HP:0001250): A seizure is an intermittent abnormality of nervous system physiology characterized by a transient occurrence of signs and/or symptoms due to abnormal excessive or synchronous neuronal activity in the brain. Evidence: PCS. Frequency: 19/19. Onset: Infantile onset (HP:0003593). (PMID:30351409)
- Febrile seizure (within the age range of 3 months to 6 years) (HP:0002373): A febrile seizure is any type of seizure (most often a generalized tonic-clonic seizure) occurring with fever (at least 38 degrees Celsius) but in the absence of central nervous system infection, severe metabolic disturbance or other alternative precipitant in children between the ages of 3 months and 6 years. Evidence: IEA. (OMIM:618482)
- Generalized non-motor (absence) seizure (HP:0002121): A generalized non-motor (absence) seizure is a type of a type of dialeptic seizure that is of electrographically generalized onset. It is a generalized seizure characterized by an interruption of activities, a blank stare, and usually the person will be unresponsive when spoken to. Any ictal motor phenomena are minor in comparison to these non-motor features. Evidence: IEA. (OMIM:618482)
- Autistic behavior (HP:0000729): Persistent deficits in social interaction and communication and interaction as well as a markedly restricted repertoire of activity and interest as well as repetitive patterns of behavior. Evidence: PCS. Frequency: 3/19. (PMID:30351409)
- Global developmental delay (HP:0001263): A delay in the achievement of motor or mental milestones in the domains of development of a child, including motor skills, speech and language, cognitive skills, and social and emotional skills. This term should only be used to describe children younger than five years of age. Evidence: IEA. Frequency: Very rare (HP:0040284). (OMIM:618482)
- Typified by incomplete penetrance (HP:0003829): Description of conditions in which not all individuals with a given genotype exhibit the disease. Penetrance is the proportion that develop disease given a lifespan of 80 years. Evidence: IEA. (OMIM:618482)
- Autosomal dominant inheritance (HP:0000006): A mode of inheritance that is observed for traits related to a gene encoded on one of the autosomes (i.e., the human chromosomes 1-22) in which a trait manifests in heterozygotes. In the context of medical genetics, an autosomal dominant disorder is caused when a single copy of the mutant allele is present. Males and females are affected equally, and can both transmit the disorder with a risk of 50% for each child of inheriting the mutant allele. Evidence: PCS. (PMID:30351409)
- Intellectual disability (HP:0001249): The term intellectual disability or intellectual developmental disorder is used to describe significantly sub-average intellectual and adaptive functioning based on clinical assessment and as measured by individually administered, appropriately normed, standardized and validated tests of intellectual functioning and adaptive behavior, with onset during the developmental period from infancy through adolescence. Evidence: PCS. Frequency: 13/19. (PMID:30351409)
These phenotypes are associated with the disease generalized epilepsy with febrile seizures plus, type 10 (OMIM:618482).